- Abnormal bleeding (HP:0001892): An abnormal susceptibility to bleeding, often referred to as a bleeding diathesis. A bleeding diathesis may be related to vascular, platelet and coagulation defects. Evidence: TAS. (OMIM:613329)
- Menorrhagia (HP:0000132): Prolonged and excessive menses at regular intervals in excess of 80 mL or lasting longer than 7 days. Evidence: TAS. (OMIM:613329)
- Congenital onset (HP:0003577): A phenotypic abnormality that is present at birth. Evidence: TAS. (OMIM:613329)
- Autosomal recessive inheritance (HP:0000007): A mode of inheritance that is observed for traits related to a gene encoded on one of the autosomes (i.e., the human chromosomes 1-22) in which a trait manifests in individuals with two pathogenic alleles, either homozygotes (two copies of the same mutant allele) or compound heterozygotes (whereby each copy of a gene has a distinct mutant allele). Evidence: TAS. (OMIM:613329)
- Autosomal dominant inheritance (HP:0000006): A mode of inheritance that is observed for traits related to a gene encoded on one of the autosomes (i.e., the human chromosomes 1-22) in which a trait manifests in heterozygotes. In the context of medical genetics, an autosomal dominant disorder is caused when a single copy of the mutant allele is present. Males and females are affected equally, and can both transmit the disorder with a risk of 50% for each child of inheriting the mutant allele. Evidence: TAS. (OMIM:613329)
These phenotypes are associated with the disease congenital plasminogen activator inhibitor type 1 deficiency (OMIM:613329).